Phenotypes associated with the disease Pituitary dermoid and epidermoid cysts (ORPHA:91351):
- Anterior hypopituitarism (HP:0000830): A condition of reduced function of the anterior pituitary gland characterized by decreased secretion of one or more of the pituitary hormones growth hormone, thyroid-stimulating hormone, adrenocorticotropic hormone, prolactin, luteinizing hormone, and follicle-stimulating hormone. Evidence: TAS. Frequency: Very frequent (HP:0040281). (ORPHA:91351)
- Nausea and vomiting (HP:0002017): Nausea is a commonly encountered symptom that has been defined as an unpleasant painless subjective feeling that one will imminently vomit. Vomiting has been defined as the forceful expulsion of the contents of the stomach, duodenum, or jejunum through the oral cavity. While nausea and vomiting are often thought to exist on a temporal continuum, this is not always the case. There are situations when severe nausea may be present without emesis and less frequently, when emesis may be present without preceding nausea. Evidence: TAS. Frequency: Very frequent (HP:0040281). (ORPHA:91351)
- Avascular necrosis (HP:0010885): A disease where there is cellular death (necrosis) of bone components due to interruption of the blood supply. Evidence: TAS. Frequency: Very frequent (HP:0040281). (ORPHA:91351)
- Neoplasm of the anterior pituitary (HP:0011750): A tumor (abnormal growth of tissue) of the adenohypophysis, which is also known as the anterior lobe of the pituitary gland. Evidence: TAS. Frequency: Very frequent (HP:0040281). (ORPHA:91351)
- Hypogonadism (HP:0000135): A decreased functionality of the gonad. Evidence: TAS. Frequency: Frequent (HP:0040282). (ORPHA:91351)
- Amenorrhea (HP:0000141): Absence of menses for an interval of time equivalent to a total of more than (or equal to) 3 previous cycles or 6 months. Evidence: TAS. Frequency: Frequent (HP:0040282). (ORPHA:91351)
- Diplopia (HP:0000651): Diplopia is a condition in which a single object is perceived as two images, it is also known as double vision. Evidence: TAS. Frequency: Frequent (HP:0040282). (ORPHA:91351)
- Increased circulating prolactin concentration (HP:0000870): The presence of abnormally increased levels of prolactin in the blood. Prolactin is a peptide hormone produced by the anterior pituitary gland that plays a role in breast development and lactation during pregnancy. Evidence: TAS. Frequency: Frequent (HP:0040282). (ORPHA:91351)
- Panhypopituitarism (HP:0000871): A pituitary functional deficit affecting all the anterior pituitary hormones (growth hormone, thyroid-stimulating hormone, follicle-stimulating hormone, luteinizing hormone, adrenocorticotropic hormone, and prolactin). Evidence: TAS. Frequency: Frequent (HP:0040282). (ORPHA:91351)
- Oligomenorrhea (HP:0000876): Infrequent menses (less than 6 per year or more than 35 days between cycles). Evidence: TAS. Frequency: Frequent (HP:0040282). (ORPHA:91351)
- Recurrent paroxysmal headache (HP:0002331): Repeated episodes of headache with rapid onset, reaching a peak within minutes and of short duration (less than one hour) with pain that is throbbing, pulsating, or bursting in quality. Evidence: TAS. Frequency: Frequent (HP:0040282). (ORPHA:91351)
- Generalized muscle weakness (HP:0003324): Generalized weakness or decreased strength of the muscles, affecting both distal and proximal musculature. Evidence: TAS. Frequency: Frequent (HP:0040282). (ORPHA:91351)
- Reduced visual acuity (HP:0007663). Evidence: TAS. Frequency: Frequent (HP:0040282). (ORPHA:91351)
- Hyperpituitarism (HP:0010514): Hypersecretion of one or more pituitary hormones. This can occur in conditions in which deficiency in the target organ leads to decreased hormonal feedback, or as a primary condition most usually in connection with a pituitary adenoma. Evidence: TAS. Frequency: Frequent (HP:0040282). (ORPHA:91351)
- Enlarged pituitary gland (HP:0012505): An abnormally increased size of the pituitary gland. Evidence: TAS. Frequency: Frequent (HP:0040282). (ORPHA:91351)
- Thunderclap headache (HP:0030907): Severe head pain with sudden onset, reaching its maximum intensity in less than one minute and lasting from one hour to ten days. Evidence: TAS. Frequency: Frequent (HP:0040282). (ORPHA:91351)
- Galactorrhea (HP:0100829): Spontaneous flow of milk from the breast, unassociated with childbirth or nursing. Evidence: TAS. Frequency: Frequent (HP:0040282). (ORPHA:91351)
- Oligozoospermia (HP:0000798): Reduced count of spermatozoa in the semen, defined as a sperm count below 20 million per milliliter semen. Evidence: TAS. Frequency: Occasional (HP:0040283). (ORPHA:91351)
- Seizure (HP:0001250): A seizure is an intermittent abnormality of nervous system physiology characterized by a transient occurrence of signs and/or symptoms due to abnormal excessive or synchronous neuronal activity in the brain. Evidence: TAS. Frequency: Occasional (HP:0040283). (ORPHA:91351)
- Meningitis (HP:0001287): Inflammation of the meninges. Evidence: TAS. Frequency: Occasional (HP:0040283). (ORPHA:91351)
- Abnormal central motor function (HP:0011442): An anomaly of the control or production of movement in the central nervous system. Evidence: TAS. Frequency: Occasional (HP:0040283). (ORPHA:91351)
- Abnormal central sensory function (HP:0011730): An abnormality of sensation related to CNS function. Assuming the primary sensory modalities are intact and the patient is alert and cooperative, the presence of an abnormality of sensory function may indicate a lesion of a parietal cortex, the thalamocortical projections to the parietal cortex, or the spinal cord. Evidence: TAS. Frequency: Occasional (HP:0040283). (ORPHA:91351)
- Sudden loss of visual acuity (HP:0001117): Severe loss of visual acuity within hours or days. This is characteristic of Leber hereditary optic neuropathy. Evidence: TAS. Frequency: Very rare (HP:0040284). (ORPHA:91351)
- Polydipsia (HP:0001959): Excessive thirst manifested by excessive fluid intake. Evidence: TAS. Frequency: Very rare (HP:0040284). (ORPHA:91351)